Phenotypes associated with the disease Mosaic trisomy 15 syndrome (ORPHA:1706):
- Abnormality of the nervous system (HP:0000707): An abnormality of the nervous system. Evidence: TAS. Frequency: Very frequent (HP:0040281). (ORPHA:1706)
- Abnormality of the hand (HP:0001155): An abnormality affecting one or both hands. Evidence: TAS. Frequency: Very frequent (HP:0040281). (ORPHA:1706)
- Hypotonia (HP:0001252): Hypotonia is an abnormally low muscle tone (the amount of tension or resistance to movement in a muscle). Even when relaxed, muscles have a continuous and passive partial contraction which provides some resistance to passive stretching. Hypotonia thus manifests as diminished resistance to passive stretching. Hypotonia is not the same as muscle weakness, although the two conditions can co-exist. Evidence: TAS. Frequency: Very frequent (HP:0040281). (ORPHA:1706)
- Abnormality of chromosome segregation (HP:0002916): An abnormality of chromosome segregation. Evidence: TAS. Frequency: Frequent (HP:0040282). (ORPHA:1706)
- Deviation of finger (HP:0004097): Deviated fingers is a term that should be used if one or more fingers of the hand are deviated from their normal position, either to the radial or ulnar side. A deviation of a finger can be caused by an abnormal form of one or more of the phalanges of the affected finger, or by a deviation or displacement of one or more phalanges. Evidence: TAS. Frequency: Frequent (HP:0040282). (ORPHA:1706)
- Camptodactyly of finger (HP:0100490): The distal interphalangeal joint and/or the proximal interphalangeal joint of the fingers cannot be extended to 180 degrees by either active or passive extension. Evidence: TAS. Frequency: Frequent (HP:0040282). (ORPHA:1706)